Phenotypes associated with the disease Usher syndrome type 1E (OMIM:602097):
- Areflexia (HP:0001284): Absence of neurologic reflexes such as the knee-jerk reaction. Evidence: IEA. (OMIM:602097)
- Autosomal recessive inheritance (HP:0000007): A mode of inheritance that is observed for traits related to a gene encoded on one of the autosomes (i.e., the human chromosomes 1-22) in which a trait manifests in individuals with two pathogenic alleles, either homozygotes (two copies of the same mutant allele) or compound heterozygotes (whereby each copy of a gene has a distinct mutant allele). Evidence: IEA. (OMIM:602097)
- Rod-cone dystrophy (HP:0000510): An inherited retinal disease subtype in which the rod photoreceptors appear to be more severely affected than the cone photoreceptors. Typical presentation is with nyctalopia (due to rod dysfunction) followed by loss of mid-peripheral field of vision, which gradually extends and leaves many patients with a small central island of vision due to the preservation of macular cones. Evidence: IEA. (OMIM:602097)
- Vestibular areflexia (HP:0008568): Vestibular areflexia can be measured as the absence of the caloric nystagmus response in electronystagmography. Evidence: IEA. (OMIM:602097)
- Congenital sensorineural hearing impairment (HP:0008527): A type of hearing impairment caused by an abnormal functionality of the cochlear nerve with congenital onset. Evidence: IEA. (OMIM:602097)